Phenotypes associated with the disease thrombocytopenia 10 (OMIM:620484, an entry in Online Mendelian Inheritance in Man):
- Menorrhagia (HP:0000132, a Human Phenotype Ontology term): Prolonged and excessive menses at regular intervals in excess of 80 mL or lasting longer than 7 days. Evidence: PCS. Frequency: 1/1. (PMID:30591527)
- Abnormal bleeding (HP:0001892, a Human Phenotype Ontology term): An abnormal susceptibility to bleeding, often referred to as a bleeding diathesis. A bleeding diathesis may be related to vascular, platelet and coagulation defects. Evidence: PCS. Frequency: 2/2. (PMID:30591527)
- Congenital onset (HP:0003577, a Human Phenotype Ontology term): A phenotypic abnormality that is present at birth. Evidence: PCS. Frequency: 2/2. (PMID:30591527)
- Autosomal recessive inheritance (HP:0000007, a Human Phenotype Ontology term): A mode of inheritance that is observed for traits related to a gene encoded on one of the autosomes (i.e., the human chromosomes 1-22) in which a trait manifests in individuals with two pathogenic alleles, either homozygotes (two copies of the same mutant allele) or compound heterozygotes (whereby each copy of a gene has a distinct mutant allele). Evidence: PCS. (PMID:30591527)
- Bruising susceptibility (HP:0000978, a Human Phenotype Ontology term): An ecchymosis (bruise) refers to the skin discoloration caused by the escape of blood into the tissues from ruptured blood vessels. This term refers to an abnormally increased susceptibility to bruising. The corresponding phenotypic abnormality is generally elicited on medical history as a report of frequent ecchymoses or bruising without adequate trauma. Evidence: PCS. Frequency: 1/2. (PMID:30591527)
- Petechiae (HP:0000967, a Human Phenotype Ontology term): Petechiae are pinpoint-sized reddish/purple spots, resembling a rash, that appear just under the skin or a mucous membrane when capillaries have ruptured and some superficial bleeding into the skin has happened. This term refers to an abnormally increased susceptibility to developing petechiae. Evidence: PCS. Frequency: 1/2. (PMID:30591527)
- Spontaneous, recurrent epistaxis (HP:0004406, a Human Phenotype Ontology term). Evidence: PCS. Frequency: 1/2. (PMID:30591527)
- Thrombocytopenia (HP:0001873, a Human Phenotype Ontology term): A reduction in the number of circulating thrombocytes. Evidence: PCS. Frequency: 2/2. Onset: Congenital onset (HP:0003577, a Human Phenotype Ontology term). (PMID:30591527)
- Decreased mean platelet volume (HP:0005537, a Human Phenotype Ontology term): Average platelet volume below the lower limit of the normal reference interval. Evidence: PCS. Frequency: 2/2. (PMID:30591527)